Phenotypes associated with the disease spinal arachnoiditis (OMIM:182950):
- Abnormality of the skeletal system (HP:0000924): An abnormality of the skeletal system. Evidence: IEA. (OMIM:182950)
- Abnormality of metabolism/homeostasis (HP:0001939). Evidence: IEA. (OMIM:182950)
- Autosomal dominant inheritance (HP:0000006): A mode of inheritance that is observed for traits related to a gene encoded on one of the autosomes (i.e., the human chromosomes 1-22) in which a trait manifests in heterozygotes. In the context of medical genetics, an autosomal dominant disorder is caused when a single copy of the mutant allele is present. Males and females are affected equally, and can both transmit the disorder with a risk of 50% for each child of inheriting the mutant allele. Evidence: IEA. (OMIM:182950)
- Spastic paraparesis (HP:0002313): Partial loss of the ability to move the lower limbs accompanied by spasticity of the lower limbs. Evidence: IEA. (OMIM:182950)